- Increased nuchal translucency (HP:0010880): Nuchal translucency is the sonographic appearance of subcutaneous accumulation of liquid in the back of the fetal neck in the first trimester of pregnancy (11-14 gestational weeks of pregnancy). Evidence: TAS. Frequency: Occasional (HP:0040283). (ORPHA:1692)
- Congenital diaphragmatic hernia (HP:0000776): The presence of a hernia of the diaphragm present at birth. Evidence: TAS. Frequency: Occasional (HP:0040283). (ORPHA:1692)
- Omphalocele (HP:0001539): A midline anterior incomplete closure of the abdominal wall in which there is herniation of the abdominal viscera into the base of the abdominal cord. Evidence: TAS. Frequency: Occasional (HP:0040283). (ORPHA:1692)
- Renal cyst (HP:0000107): A fluid filled sac in the kidney. Evidence: TAS. Frequency: Occasional (HP:0040283). (ORPHA:1692)
- Microphthalmia (HP:0000568): A developmental anomaly characterized by abnormal smallness of one or both eyes. Evidence: TAS. Frequency: Occasional (HP:0040283). (ORPHA:1692)
- Lateral ventricle dilatation (HP:0006956). Evidence: TAS. Frequency: Occasional (HP:0040283). (ORPHA:1692)
- Agenesis of corpus callosum (HP:0001274): Absence of the corpus callosum as a result of the failure of the corpus callosum to develop, which can be the result of a failure in any one of the multiple steps of callosal development including cellular proliferation and migration, axonal growth or glial patterning at the midline. Evidence: TAS. Frequency: Occasional (HP:0040283). (ORPHA:1692)
- Cerebellar vermis hypoplasia (HP:0001320): Underdevelopment of the vermis of cerebellum. Evidence: TAS. Frequency: Occasional (HP:0040283). (ORPHA:1692)
- Camptodactyly of finger (HP:0100490): The distal interphalangeal joint and/or the proximal interphalangeal joint of the fingers cannot be extended to 180 degrees by either active or passive extension. Evidence: TAS. Frequency: Occasional (HP:0040283). (ORPHA:1692)
- 2-3 finger cutaneous syndactyly (HP:0001233): A soft tissue continuity in the anteroposterior axis between the second to the third fingers that extends distally to at least the level of the proximal interphalangeal joints. Evidence: TAS. Frequency: Occasional (HP:0040283). (ORPHA:1692)
- Hypoplastic thumbnail (HP:0012553): A thumbnail that is diminished in length and width, i.e., underdeveloped thumb nail. Evidence: TAS. Frequency: Occasional (HP:0040283). (ORPHA:1692)
- Pulmonary hypoplasia (HP:0002089). Evidence: TAS. Frequency: Occasional (HP:0040283). (ORPHA:1692)
- Coarse facial features (HP:0000280): Absence of fine and sharp appearance of brows, nose, lips, mouth, and chin, usually because of rounded and heavy features or thickened skin with or without thickening of subcutaneous and bony tissues. Evidence: TAS. Frequency: Occasional (HP:0040283). (ORPHA:1692)
- Depressed nasal bridge (HP:0005280): Posterior positioning of the nasal root in relation to the overall facial profile for age. Evidence: TAS. Frequency: Occasional (HP:0040283). (ORPHA:1692)
- Wide nasal bridge (HP:0000431): Increased breadth of the nasal bridge (and with it, the nasal root). Evidence: TAS. Frequency: Occasional (HP:0040283). (ORPHA:1692)
- Low-set ears (HP:0000369): Upper insertion of the ear to the scalp below an imaginary horizontal line drawn between the inner canthi of the eye and extending posteriorly to the ear. Evidence: TAS. Frequency: Occasional (HP:0040283). (ORPHA:1692)
- Wide mouth (HP:0000154): Distance between the oral commissures more than 2 SD above the mean. Alternatively, an apparently increased width of the oral aperture (subjective). Evidence: TAS. Frequency: Occasional (HP:0040283). (ORPHA:1692)
- Microretrognathia (HP:0000308): A form of developmental hypoplasia of the mandible in which the mandible is mislocalised posteriorly. Evidence: TAS. Frequency: Occasional (HP:0040283). (ORPHA:1692)
- Polyhydramnios (HP:0001561): The presence of excess amniotic fluid in the uterus during pregnancy. Evidence: TAS. Frequency: Occasional (HP:0040283). (ORPHA:1692)
- Opacification of the corneal stroma (HP:0007759): Reduced transparency of the stroma of cornea. Evidence: TAS. Frequency: Occasional (HP:0040283). (ORPHA:1692)
- Orofacial cleft (HP:0000202): The presence of a cleft (gap, opening, or groove) in the oral cavity, including cleft of the upper lip and/or cleft of the palate. Cleft of the upper lip is visible as a groove or fissure in the lip, most frequently due to a congenital failure of the maxillary and median nasal processes to fuse. Cleft palate is characterized by a grooved depression or fissure in the roof of the mouth, most often resulting from a congenital failure of the palate to fuse properly. Clefts of the lip and palate can occur individually or together. It is preferable to code each defect separately. Evidence: TAS. Frequency: Occasional (HP:0040283). (ORPHA:1692)
- Renal cortical cysts (HP:0000803): Cysts of the cortex of the kidney. Evidence: TAS. Frequency: Occasional (HP:0040283). (ORPHA:1692)
- Posterior fossa cyst (HP:0007291): A discrete posterior fossa cerebrospinal fluid (CSF) collection that does not communicate directly with the fourth ventricle. Evidence: TAS. Frequency: Occasional (HP:0040283). (ORPHA:1692)
- Enlarged cisterna magna (HP:0002280): Increase in size of the cisterna magna, one of three principal openings in the subarachnoid space between the arachnoid and pia mater, located between the cerebellum and the dorsal surface of the medulla oblongata. Evidence: TAS. Frequency: Occasional (HP:0040283). (ORPHA:1692)
- Cleft palate (HP:0000175): Cleft palate is a developmental defect of the palate resulting from a failure of fusion of the palatine processes and manifesting as a separation of the roof of the mouth (soft and hard palate). Evidence: TAS. Frequency: Occasional (HP:0040283). (ORPHA:1692)
- Hand clenching (HP:0001188): An abnormal hand posture in which the hands are clenched to fists. All digits held completely flexed at the metacarpophalangeal and interphalangeal joints. In prenatal sonography of the fetal clenched hand, the index finger overlaps a clenched fist formed by the other digits. The proximal interphalangeal articulation of the index finger is flexed and ulnarly deviated, and the thumb is adducted. Evidence: TAS. Frequency: Occasional (HP:0040283). (ORPHA:1692)
- Rocker bottom foot (HP:0001838): The presence of both a prominent heel and a convex contour of the sole. Evidence: TAS. Frequency: Occasional (HP:0040283). (ORPHA:1692)
- Abnormal pinna morphology (HP:0000377): An abnormality of the pinna, which is also referred to as the auricle or external ear. Evidence: TAS. Frequency: Occasional (HP:0040283). (ORPHA:1692)
- Macrocephaly (HP:0000256): Occipitofrontal (head) circumference greater than 97th centile compared to appropriate, age matched, sex-matched normal standards. Alternatively, a apparently increased size of the cranium. Evidence: TAS. Frequency: Occasional (HP:0040283). (ORPHA:1692)
- Frontal bossing (HP:0002007): Bilateral bulging of the lateral frontal bone prominences with relative sparing of the midline. Evidence: TAS. Frequency: Occasional (HP:0040283). (ORPHA:1692)
- Micropenis (HP:0000054): Abnormally small penis. At birth, the normal penis is about 3 cm (stretched length from pubic tubercle to tip of penis) with micropenis less than 2.0-2.5 cm. Evidence: TAS. Frequency: Occasional (HP:0040283). (ORPHA:1692)
- Arachnodactyly (HP:0001166): Abnormally long and slender fingers (spider fingers). Evidence: TAS. Frequency: Occasional (HP:0040283). (ORPHA:1692)
- Small nail (HP:0001792): A nail that is diminished in length and width, i.e., underdeveloped nail. Evidence: TAS. Frequency: Occasional (HP:0040283). (ORPHA:1692)
- Complete duplication of thumb phalanx (HP:0009943): A complete duplication affecting one or more of the phalanges of the thumb. As opposed to a partial duplication were there is still a variable degree of fusion between the duplicated bones, a complete duplication leads to two separate bones appearing side to side (radio-ulnar axis) as seen on x-rays. A duplication leading to an accessory bone appearing in the proximo-distal axis on x-rays, this is actually a different entity called a Pseudoepiphyses (see according terms) sometimes also referred to as Hyperphalangism. Evidence: TAS. Frequency: Occasional (HP:0040283). (ORPHA:1692)
- Toe syndactyly (HP:0001770): Webbing or fusion of the toes, involving soft parts only or including bone structure. Bony fusions are referred to as "bony" Syndactyly if the fusion occurs in a radio-ulnar axis. Fusions of bones of the toes in a proximo-distal axis are referred to as "Symphalangism". Evidence: TAS. Frequency: Occasional (HP:0040283). (ORPHA:1692)
- Broad 2nd toe (HP:0100040): A broad appearance of the second toe. Evidence: TAS. Frequency: Occasional (HP:0040283). (ORPHA:1692)
- Deviation of the 5th toe (HP:0010344). Evidence: TAS. Frequency: Occasional (HP:0040283). (ORPHA:1692)
- Broad toe (HP:0001837): Visible increase in width of the non-hallux digit without an increase in the dorso-ventral dimension. Evidence: TAS. Frequency: Occasional (HP:0040283). (ORPHA:1692)
- Polymicrogyria (HP:0002126): Polymicrogyria is a congenital malformation of the cerebral cortex characterized by abnormal cortical layering (lamination) and an excessive number of small gyri (folds). Evidence: TAS. Frequency: Occasional (HP:0040283). (ORPHA:1692)
- Cerebellar hypoplasia (HP:0001321): Cerebellar hypoplasia is a descriptive term implying a cerebellum with a reduced volume, but a normal shape and is stable over time. Evidence: TAS. Frequency: Occasional (HP:0040283). (ORPHA:1692)
- Elbow flexion contracture (HP:0002987): An elbow contracture that limits the ability of the elbow joint to be extended (straightened), meaning that the elbow is fixed in an flexed (bent) position. Evidence: TAS. Frequency: Occasional (HP:0040283). (ORPHA:1692)
- Penile hypospadias (HP:0003244): Location of the urethral opening on the inferior aspect of the penis. Evidence: TAS. Frequency: Occasional (HP:0040283). (ORPHA:1692)
- Single transverse palmar crease (HP:0000954): The distal and proximal transverse palmar creases are merged into a single transverse palmar crease. Evidence: TAS. Frequency: Occasional (HP:0040283). (ORPHA:1692)
- Long toe (HP:0010511): Toes that appear disproportionately long compared to the foot. Evidence: TAS. Frequency: Occasional (HP:0040283). (ORPHA:1692)
- Facial asymmetry (HP:0000324): An abnormal difference between the left and right sides of the face. Evidence: TAS. Frequency: Occasional (HP:0040283). (ORPHA:1692)
- Congenital bilateral ptosis (HP:0007911). Evidence: TAS. Frequency: Occasional (HP:0040283). (ORPHA:1692)
- Thick lower lip vermilion (HP:0000179): Increased thickness of the lower lip, leading to a prominent appearance of the lower lip. The height of the vermilion of the lower lip in the midline is more than 2 SD above the mean. Alternatively, an apparently increased height of the vermilion of the lower lip in the frontal view (subjective). Evidence: TAS. Frequency: Occasional (HP:0040283). (ORPHA:1692)
- Short upper lip (HP:0000188): Decreased width of the upper lip. Evidence: TAS. Frequency: Occasional (HP:0040283). (ORPHA:1692)
- Absent distal interphalangeal creases (HP:0001032): Absence of the distal interphalangeal flexion creases of the fingers. Evidence: TAS. Frequency: Occasional (HP:0040283). (ORPHA:1692)
- Thoracic scoliosis (HP:0002943). Evidence: TAS. Frequency: Occasional (HP:0040283). (ORPHA:1692)
- Knee joint hypermobility (HP:0045086): The ability of the knee to move past its normal range of motion, (knee hyperextension is greater than 10 degrees). Evidence: TAS. Frequency: Occasional (HP:0040283). (ORPHA:1692)
- Pulmonary artery atresia (HP:0004935): A congenital anomaly with a narrowing or complete absence of the opening between the right ventricle and the pulmonary artery. Evidence: TAS. Frequency: Occasional (HP:0040283). (ORPHA:1692)
- Ventricular septal defect (HP:0001629): A hole between the two bottom chambers (ventricles) of the heart. The defect is centered around the most superior aspect of the ventricular septum. Evidence: TAS. Frequency: Occasional (HP:0040283). (ORPHA:1692)
- Moderate intellectual disability (HP:0002342): Moderate intellectual disability (ID) is defined as a type of ID characterized by moderately sub-average adaptive functioning and intellectual functioning, with an intelligence quotient (IQ) the range of 35-49. Evidence: TAS. Frequency: Occasional (HP:0040283). (ORPHA:1692)
- Single umbilical artery (HP:0001195): Single umbilical artery (SUA) is the absence of one of the two umbilical arteries surrounding the fetal bladder and in the fetal umbilical cord. Evidence: TAS. Frequency: Occasional (HP:0040283). (ORPHA:1692)
- Small anterior fontanelle (HP:0000237): Abnormally decreased size of the anterior fontanelle with respect to age-dependent norms. Evidence: TAS. Frequency: Occasional (HP:0040283). (ORPHA:1692)
- Downslanted palpebral fissures (HP:0000494): The palpebral fissure inclination is more than two standard deviations below the mean. Evidence: TAS. Frequency: Occasional (HP:0040283). (ORPHA:1692)
- Coarctation of aorta (HP:0001680): Coarctation of the aorta is a narrowing or constriction of a segment of the aorta. Evidence: TAS. Frequency: Occasional (HP:0040283). (ORPHA:1692)
- Finger clinodactyly (HP:0040019). Evidence: TAS. Frequency: Occasional (HP:0040283). (ORPHA:1692)
- Hepatic agenesis (HP:0100839): Absence of the liver owing to a failure of the liver to develop. Evidence: TAS. Frequency: Occasional (HP:0040283). (ORPHA:1692)
These phenotypes are associated with the disease Mosaic trisomy 1 syndrome (ORPHA:1692).